- Non-Mendelian inheritance (HP:0001426): A mode of inheritance that depends on genetic determinants in more than one gene. Evidence: PCS. (PMID:15210948)
- Hip osteoarthritis (HP:0008843). Evidence: PCS. (PMID:15210948)
These phenotypes are associated with the disease osteoarthritis susceptibility 1 (OMIM:165720).